Phenotypes associated with the disease chylous ascites (OMIM:208300):
- Autosomal recessive inheritance (HP:0000007): A mode of inheritance that is observed for traits related to a gene encoded on one of the autosomes (i.e., the human chromosomes 1-22) in which a trait manifests in individuals with two pathogenic alleles, either homozygotes (two copies of the same mutant allele) or compound heterozygotes (whereby each copy of a gene has a distinct mutant allele). Evidence: IEA. (OMIM:208300)
- Chylous ascites (HP:0012281): Extravasation of chyle into the peritoneal cavity. Evidence: TAS. Onset: Congenital onset (HP:0003577). (OMIM:208300)
- Glaucoma (HP:0000501): Glaucoma refers loss of retinal ganglion cells in a characteristic pattern of optic neuropathy usually associated with increased intraocular pressure. Evidence: TAS. (OMIM:208300)